- Abnormal left ventricle morphology (HP:0001711): Any structural abnormality of the left ventricle of the heart. Evidence: TAS. Frequency: Obligate (HP:0040280). (ORPHA:1055)
- Congestive heart failure (HP:0001635): The presence of an abnormality of cardiac function that is responsible for the failure of the heart to pump blood at a rate that is commensurate with the needs of the tissues or a state in which abnormally elevated filling pressures are required for the heart to do so. Heart failure is frequently related to a defect in myocardial contraction. Evidence: TAS. Frequency: Frequent (HP:0040282). (ORPHA:1055)
- Apnea (HP:0002104): Lack of breathing with no movement of the respiratory muscles and no exchange of air in the lungs. This term refers to a disposition to have recurrent episodes of apnea rather than to a single event. Evidence: TAS. Frequency: Occasional (HP:0040283). (ORPHA:1055)
- Abnormal T-wave (HP:0005135): An abnormality of the T wave on the electrocardiogram, which mainly represents the repolarization of the ventricles. Evidence: TAS. Frequency: Occasional (HP:0040283). (ORPHA:1055)
- Arrhythmia (HP:0011675): Any cardiac rhythm other than the normal sinus rhythm. Such a rhythm may be either of sinus or ectopic origin and either regular or irregular. An arrhythmia may be due to a disturbance in impulse formation or conduction or both. Evidence: TAS. Frequency: Occasional (HP:0040283). (ORPHA:1055)
- Abnormal ST segment (HP:0012249): An electrocardiographic anomaly of the ST segment, which is the segment that connects the QRS complex and the T wave. The ST segment normally has a duration of 80 to 120 ms, is flat and at the same level (isoelectric) as the PR and TP segment. Evidence: TAS. Frequency: Occasional (HP:0040283). (ORPHA:1055)
These phenotypes are associated with the disease Congenital left ventricular aneurysm (ORPHA:1055).